Phenotypes associated with the disease Ververi-Brady syndrome 1 (OMIM:617982):
- Upslanted palpebral fissure (HP:0000582): The palpebral fissure inclination is more than two standard deviations above the mean for age (objective); or, the inclination of the palpebral fissure is greater than typical for age. Evidence: PCS. Frequency: 1/3. (PMID:28692176)
- Congenital onset (HP:0003577): A phenotypic abnormality that is present at birth. Evidence: PCS. Frequency: 2/2. (PMID:30281152)
- Short stature (HP:0004322): A height below that which is expected according to age and gender norms. Although there is no universally accepted definition of short stature, many refer to "short stature" as height more than 2 standard deviations below the mean for age and gender (or below the 3rd percentile for age and gender dependent norms). Evidence: PCS. Frequency: 1/2. (PMID:30281152)
- Single umbilical artery (HP:0001195): Single umbilical artery (SUA) is the absence of one of the two umbilical arteries surrounding the fetal bladder and in the fetal umbilical cord. Evidence: PCS. Frequency: 1/2. (PMID:30281152)
- Hypotonia (HP:0001252): Hypotonia is an abnormally low muscle tone (the amount of tension or resistance to movement in a muscle). Even when relaxed, muscles have a continuous and passive partial contraction which provides some resistance to passive stretching. Hypotonia thus manifests as diminished resistance to passive stretching. Hypotonia is not the same as muscle weakness, although the two conditions can co-exist. Evidence: PCS. Frequency: 2/5. (PMID:30281152;PMID:28692176)
- Motor delay (HP:0001270): A type of Developmental delay characterized by a delay in acquiring motor skills. Evidence: PCS. Frequency: 4/5. (PMID:30281152;PMID:28692176)
- Intention tremor (HP:0002080): A type of kinetic tremor that occurs during target directed movement is called intention tremor. That is, an oscillatory cerebellar ataxia that tends to be absent when the limbs are inactive and during the first part of voluntary movement but worsening as the movement continues and greater precision is required (e.g., in touching a target such as the patient's nose or a physician's finger). Evidence: PCS. Frequency: 1/3. (PMID:28692176)
- Smooth philtrum (HP:0000319): Flat skin surface, with no ridge formation in the central region of the upper lip between the nasal base and upper vermilion border. Evidence: PCS. Frequency: 1/3. (PMID:28692176)
- Hypertelorism (HP:0000316): Interpupillary distance more than 2 SD above the mean (alternatively, the appearance of an increased interpupillary distance or widely spaced eyes). Evidence: PCS. Frequency: 1/3. (PMID:28692176)
- Transposition of the great arteries (HP:0001669): A complex congenital heart defect in which the aorta arises from the morphologic right ventricle and the pulmonary artery arises from the morphologic left ventricle. Evidence: PCS. Frequency: 1/2. (PMID:30281152)
- Bulbous nose (HP:0000414): Increased volume and globular shape of the anteroinferior aspect of the nose. Evidence: PCS. Frequency: 1/2. (PMID:30281152)
- Thin upper lip vermilion (HP:0000219): Height of the vermilion of the upper lip in the midline more than 2 SD below the mean. Alternatively, an apparently reduced height of the vermilion of the upper lip in the frontal view (subjective). Evidence: PCS. Frequency: 4/5. (PMID:30281152;PMID:28692176)
- Unsteady gait (HP:0002317). Evidence: PCS. Frequency: 1/3. (PMID:28692176)
- High palate (HP:0000218): Height of the palate more than 2 SD above the mean (objective) or palatal height at the level of the first permanent molar more than twice the height of the teeth (subjective). Evidence: PCS. Frequency: 1/2. (PMID:30281152)
- Broad nasal tip (HP:0000455): Increase in width of the nasal tip. Evidence: PCS. Frequency: 1/3. (PMID:28692176)
- Cupped ear (HP:0000378): Laterally protruding ear that lacks antihelical folding (including absence of inferior and superior crura). Evidence: PCS. Frequency: 1/3. (PMID:28692176)
- Intellectual disability (HP:0001249): The term intellectual disability or intellectual developmental disorder is used to describe significantly sub-average intellectual and adaptive functioning based on clinical assessment and as measured by individually administered, appropriately normed, standardized and validated tests of intellectual functioning and adaptive behavior, with onset during the developmental period from infancy through adolescence. Evidence: PCS. Frequency: 3/3. (PMID:28692176)
- Hyporeflexia (HP:0001265): Reduction of neurologic reflexes such as the knee-jerk reaction. Evidence: PCS. Frequency: 1/3. (PMID:28692176)
- Wide mouth (HP:0000154): Distance between the oral commissures more than 2 SD above the mean. Alternatively, an apparently increased width of the oral aperture (subjective). Evidence: PCS. Frequency: 4/5. (PMID:30281152;PMID:28692176)
- Microcephaly (HP:0000252): Head circumference below 2 standard deviations below the mean for age and gender. Evidence: PCS. Frequency: 1/3. (PMID:28692176)
- Delayed speech and language development (HP:0000750): A degree of language development that is significantly below the norm for a child of a specified age. Evidence: PCS. Frequency: 5/5. (PMID:30281152;PMID:28692176)
- Scoliosis (HP:0002650): The presence of an abnormal lateral curvature of the spine. Evidence: PCS. Frequency: 2/2. (PMID:30281152)
- Everted lower lip vermilion (HP:0000232): An abnormal configuration of the lower lip such that it is turned outward i.e., everted, with the Inner aspect of the lower lip vermilion (normally opposing the teeth) being visible in a frontal view. Evidence: PCS. Frequency: 1/3. (PMID:28692176)
- Delayed skeletal maturation (HP:0002750): A decreased rate of skeletal maturation. Delayed skeletal maturation can be diagnosed on the basis of an estimation of the bone age from radiographs of specific bones in the human body. Evidence: PCS. Frequency: 1/2. (PMID:30281152)
- Metaphyseal irregularity (HP:0003025): Irregularity of the normally smooth surface of the metaphyses. Evidence: PCS. Frequency: 2/2. (PMID:30281152)
- Feeding difficulties (HP:0011968): Impaired ability to eat related to problems gathering food and getting ready to suck, chew, or swallow it. Evidence: PCS. Frequency: 1/2. (PMID:30281152)
- Mildly elevated creatine kinase (HP:0008180). Evidence: PCS. Frequency: 2/3. Onset: Childhood onset (HP:0011463). (PMID:28692176)
- Autistic behavior (HP:0000729): Persistent deficits in social interaction and communication and interaction as well as a markedly restricted repertoire of activity and interest as well as repetitive patterns of behavior. Evidence: PCS. Frequency: 1/3. (PMID:28692176)
- Ptosis (HP:0000508): The upper eyelid margin is positioned 3 mm or more lower than usual and covers the superior portion of the iris (objective); or, the upper lid margin obscures at least part of the pupil (subjective). Evidence: PCS. Frequency: 1/3. (PMID:28692176)
- Prominent nose (HP:0000448): Distance between subnasale and pronasale more than two standard deviations above the mean, or alternatively, an apparently increased anterior protrusion of the nasal tip. Evidence: PCS. Frequency: 3/3. (PMID:28692176)
- Clinodactyly of the 5th finger (HP:0004209): Clinodactyly refers to a bending or curvature of the fifth finger in the radial direction (i.e., towards the 4th finger). Evidence: PCS. Frequency: 2/2. (PMID:30281152)
- Intrauterine growth retardation (HP:0001511): An abnormal restriction of fetal growth with fetal weight below the tenth percentile for gestational age. Evidence: PCS. Frequency: 0/3. (PMID:28692176)
- Macrotia (HP:0000400): Median longitudinal ear length greater than two standard deviations above the mean and median ear width greater than two standard deviations above the mean (objective); or, apparent increase in length and width of the pinna (subjective). Evidence: PCS. Frequency: 2/2. (PMID:30281152)
- Autosomal dominant inheritance (HP:0000006): A mode of inheritance that is observed for traits related to a gene encoded on one of the autosomes (i.e., the human chromosomes 1-22) in which a trait manifests in heterozygotes. In the context of medical genetics, an autosomal dominant disorder is caused when a single copy of the mutant allele is present. Males and females are affected equally, and can both transmit the disorder with a risk of 50% for each child of inheriting the mutant allele. Evidence: PCS. (PMID:28692176)
- Low-set ears (HP:0000369): Upper insertion of the ear to the scalp below an imaginary horizontal line drawn between the inner canthi of the eye and extending posteriorly to the ear. Evidence: PCS. Frequency: 1/3. (PMID:28692176)
- Wide nose (HP:0000445): Interalar distance more than two standard deviations above the mean for age, i.e., an apparently increased width of the nasal base and alae. Evidence: PCS. Frequency: 1/3. (PMID:28692176)